- Left-to-right shunt (HP:0012382): Pattern of blood flow in the heart that deviates from the normal circuit of the circulatory system from the left side of the heart to the right. Evidence: TAS. Frequency: Very frequent (HP:0040281). (ORPHA:99105)
- Palpitations (HP:0001962): A sensation that the heart is pounding or racing, which is a non-specific sign but may be a manifestation of arrhythmia. Evidence: TAS. Frequency: Frequent (HP:0040282). (ORPHA:99105)
- Exertional dyspnea (HP:0002875): Perceived difficulty to breathe that occurs with exercise or exertion and improves with rest. Evidence: TAS. Frequency: Frequent (HP:0040282). (ORPHA:99105)
- Exercise intolerance (HP:0003546): A functional motor deficit where individuals whose responses to the challenges of exercise fail to achieve levels considered normal for their age and gender. Evidence: TAS. Frequency: Frequent (HP:0040282). (ORPHA:99105)
- Anomalous pulmonary venous return (HP:0010772): A developmental defect characterized by abnormal connection of one or more pulmonary veins to the superior or inferior vena cava, the right atrium, or the coronary sinus, resulting in a left-to-right shunt of oxygenated blood. Evidence: TAS. Frequency: Frequent (HP:0040282). (ORPHA:99105)
- Fatigue (HP:0012378): A subjective feeling of tiredness characterized by a lack of energy and motivation. Evidence: TAS. Frequency: Frequent (HP:0040282). (ORPHA:99105)
- Cardiac conduction abnormality (HP:0031546): Any anomaly of the progression of electrical impulses through the heart. Evidence: TAS. Frequency: Frequent (HP:0040282). (ORPHA:99105)
- Paradoxical splitting of the second heart sound (HP:0031663): Normally, the aortic valve closure (A2) is followed by the pulmonic valve closure (P2) but the A2-P2 interval increases with inspiration and decreases with expiration. With paradoxical splitting, there is a delay in the closure of the aortic valve, so that A2 can follow P2; the individual components can be appreciated at the end of expiration and the interval narrows with inspiration (which is the opposite of the normal pattern). Evidence: TAS. Frequency: Frequent (HP:0040282). (ORPHA:99105)
- Systolic heart murmur (HP:0031664): A heart murmur limited to systole, i.e., between the first and second heart sounds S1 and S2. Evidence: TAS. Frequency: Frequent (HP:0040282). (ORPHA:99105)
- Atrial arrhythmia (HP:0001692): A type of supraventricular tachycardia in which the atria are the principal site of electrophysiologic disturbance. Evidence: TAS. Frequency: Occasional (HP:0040283). (ORPHA:99105)
- Pulmonary arterial hypertension (HP:0002092): Pulmonary hypertension is defined mean pulmonary artery pressure of 25mmHg or more and pulmonary capillary wedge pressure of 15mmHg or less when measured by right heart catheterisation at rest and in a supine position. Evidence: TAS. Frequency: Occasional (HP:0040283). (ORPHA:99105)
- Dyspnea (HP:0002094): Difficult or labored breathing. Dyspnea is a subjective feeling only the patient can rate, e.g., on a Borg scale. Evidence: TAS. Frequency: Occasional (HP:0040283). (ORPHA:99105)
- Atrial flutter (HP:0004749): A type of atrial arrhythmia characterized by atrial rates of between 240 and 400 beats per minute and some degree of atrioventricular node conduction block. Typically, the ventricular rate is half the atrial rate. In the EKG; atrial flutter waves are observed as sawtooth-like atrial activity. Pathophysiologically, atrial flutter is a form of atrial reentry in which there is a premature electrical impulse creates a self-propagating circuit. Evidence: TAS. Frequency: Occasional (HP:0040283). (ORPHA:99105)
- Supraventricular tachycardia (HP:0004755): Supraventricular tachycardia (SVT) is an abnormally increased heart rate (over 100 beats per minute at rest) with origin above the level of the ventricles. Evidence: TAS. Frequency: Occasional (HP:0040283). (ORPHA:99105)
- Atrial fibrillation (HP:0005110): An atrial arrhythmia characterized by disorganized atrial activity without discrete P waves on the surface EKG, but instead by an undulating baseline or more sharply circumscribed atrial deflections of varying amplitude an frequency ranging from 350 to 600 per minute. Evidence: TAS. Frequency: Occasional (HP:0040283). (ORPHA:99105)
- Supraventricular arrhythmia (HP:0005115): A type of arrhythmia that originates above the ventricles, whereby the electrical impulse propagates down the normal His Purkinje system similar to normal sinus rhythm. Evidence: TAS. Frequency: Occasional (HP:0040283). (ORPHA:99105)
- Right ventricular dilatation (HP:0005133): Enlargement of the chamber of the right ventricle, which can be defined echocardiographically as a right ventricular to left ventricular ratio greater than 1:1. Evidence: TAS. Frequency: Occasional (HP:0040283). (ORPHA:99105)
- Tricuspid regurgitation (HP:0005180): Failure of the tricuspid valve to close sufficiently upon contraction of the right ventricle, causing blood to regurgitate (flow backward) into the right atrium. Evidence: TAS. Frequency: Occasional (HP:0040283). (ORPHA:99105)
- Premature atrial contractions (HP:0006699): A type of cardiac arrhythmia with premature atrial contractions or beats caused by signals originating from ectopic atrial sites. Evidence: TAS. Frequency: Occasional (HP:0040283). (ORPHA:99105)
- Automatic atrial tachycardia (HP:0011700): Chronic supraventricular tachycardia predominantly seen in childhood. Evidence: TAS. Frequency: Occasional (HP:0040283). (ORPHA:99105)
- First degree atrioventricular block (HP:0011705): Delay of conduction through the atrioventricular node, which is manifested as prolongation of the PR interval in the electrocardiogram (EKG). All atrial impulses reach the ventricles. Evidence: TAS. Frequency: Occasional (HP:0040283). (ORPHA:99105)
- Complete right bundle branch block (HP:0011712): A conduction block of the right branch of the bundle of His. This manifests as a prolongation of the QRS complex (greater than 0.12 s) with delayed activation of the right ventricle and terminal delay on the EKG. Evidence: TAS. Frequency: Occasional (HP:0040283). (ORPHA:99105)
- Junctional ectopic tachycardia (HP:0011716): Junctional ectopic tachycardia (JET) is a unique type of supraventricular arrhythmia defined by narrow QRS complex and atrioventricular (AV) dissociation or retrograde atrial conduction in a 1:1 pattern. Evidence: TAS. Frequency: Occasional (HP:0040283). (ORPHA:99105)
- Stroke (HP:0001297): Sudden impairment of blood flow to a part of the brain due to occlusion or rupture of an artery to the brain. Evidence: TAS. Frequency: Very rare (HP:0040284). (ORPHA:99105)
- Congestive heart failure (HP:0001635): The presence of an abnormality of cardiac function that is responsible for the failure of the heart to pump blood at a rate that is commensurate with the needs of the tissues or a state in which abnormally elevated filling pressures are required for the heart to do so. Heart failure is frequently related to a defect in myocardial contraction. Evidence: TAS. Frequency: Very rare (HP:0040284). (ORPHA:99105)
- Thromboembolism (HP:0001907): The formation of a blood clot inside a blood vessel that subsequently travels through the blood stream from the site where it formed to another location in the body, generally leading to vascular occlusion at the distant site. Evidence: TAS. Frequency: Very rare (HP:0040284). (ORPHA:99105)
- Airway obstruction (HP:0006536): Obstruction of conducting airways of the lung. Evidence: TAS. Frequency: Very rare (HP:0040284). (ORPHA:99105)
These phenotypes are associated with the disease Atrial septal defect, sinus venosus type (ORPHA:99105).